Phenotypes associated with the disease Gallbladder neuroendocrine tumor (ORPHA:100086):
- Biliary tract neoplasm (HP:0100574): A tumor (abnormal growth of tissue) of the biliary system. Evidence: TAS. Frequency: Obligate (HP:0040280). (ORPHA:100086)
- Neuroendocrine neoplasm (HP:0100634): A tumor that originates from a neuroendocrine cell. Evidence: TAS. Frequency: Obligate (HP:0040280). (ORPHA:100086)
- Intermittent jaundice (HP:0001046): Jaundice that is sometimes present, sometimes not. Evidence: TAS. Frequency: Frequent (HP:0040282). (ORPHA:100086)
- Cholecystitis (HP:0001082): The presence of inflammatory changes in the gallbladder. Evidence: TAS. Frequency: Frequent (HP:0040282). (ORPHA:100086)
- Ascites (HP:0001541): Accumulation of fluid in the peritoneal cavity (between the layers of the peritoneum that lines the abdomen). Evidence: TAS. Frequency: Frequent (HP:0040282). (ORPHA:100086)
- Weight loss (HP:0001824): Reduction of total body weight. Evidence: TAS. Frequency: Frequent (HP:0040282). (ORPHA:100086)
- Nausea (HP:0002018): A sensation of unease in the stomach together with an urge to vomit. Evidence: TAS. Frequency: Frequent (HP:0040282). (ORPHA:100086)
- Anorexia (HP:0002039): Lack of desire to eat (loss of appetite). Evidence: TAS. Frequency: Frequent (HP:0040282). (ORPHA:100086)
- Episodic abdominal pain (HP:0002574): An intermittent form of abdominal pain. Evidence: TAS. Frequency: Frequent (HP:0040282). (ORPHA:100086)
- Chronic noninfectious lymphadenopathy (HP:0002730): A chronic form of lymphadenopathy that is not related to infection. Evidence: TAS. Frequency: Frequent (HP:0040282). (ORPHA:100086)
- Abdominal distention (HP:0003270): Distention of the abdomen. Evidence: TAS. Frequency: Frequent (HP:0040282). (ORPHA:100086)
- Biliary tract obstruction (HP:0005230): Obstruction affecting the biliary tree. Evidence: TAS. Frequency: Frequent (HP:0040282). (ORPHA:100086)
- Elevated alkaline phosphatase of hepatic origin (HP:0010638): An abnormally increased level of liver isoforms of alkaline phosphatase, tissue-nonspecific isozyme in the blood. Evidence: TAS. Frequency: Frequent (HP:0040282). (ORPHA:100086)
- Extrahepatic cholestasis (HP:0012334): Impairment of bile flow due to obstruction in large bile ducts outside the liver. Evidence: TAS. Frequency: Frequent (HP:0040282). (ORPHA:100086)
- Chronic fatigue (HP:0012432): Subjective feeling of tiredness characterized by a lack of energy and motivation that persists for six months or longer. Evidence: TAS. Frequency: Frequent (HP:0040282). (ORPHA:100086)
- Elevated gamma-glutamyltransferase level (HP:0030948): Increased level of the enzyme gamma-glutamyltransferase (GGT). GGT is mainly present in kidney, liver, and pancreatic cells, but small amounts are present in other tissues. Evidence: TAS. Frequency: Frequent (HP:0040282). (ORPHA:100086)
- Neoplasm of the nervous system (HP:0004375): A tumor (abnormal growth of tissue) of the nervous system. Evidence: TAS. Frequency: Very rare (HP:0040284). (ORPHA:100086)
- Abnormal brain FDG positron emission tomography (HP:0012658): An anomaly detectable in [18F]-fluorodeoxyglucose (FDG) positron emission tomography (PET) brain scans. Glucose uptake measured with FDG-PET is a marker of neuronal metabolic activity. Evidence: TAS. Frequency: Very rare (HP:0040284). (ORPHA:100086)